- Hematuria (HP:0000790): The presence of blood in the urine. Hematuria may be gross hematuria (visible to the naked eye) or microscopic hematuria (detected by dipstick or microscopic examination of the urine). Evidence: TAS. Frequency: Very frequent (HP:0040281). (ORPHA:98879)
- Poor wound healing (HP:0001058): A reduced ability to heal cutaneous wounds. Evidence: TAS. Frequency: Very frequent (HP:0040281). (ORPHA:98879)
- Intracranial hemorrhage (HP:0002170): Hemorrhage occurring within the skull. Evidence: TAS. Frequency: Very frequent (HP:0040281). (ORPHA:98879)
- Prolonged bleeding time (HP:0003010): Prolongation of the time taken for a standardized skin cut of fixed depth and length to stop bleeding. Evidence: TAS. Frequency: Very frequent (HP:0040281). (ORPHA:98879)
- Prolonged partial thromboplastin time (HP:0003645): Increased time to coagulation in the partial thromboplastin time (PTT) test, a measure of the intrinsic and common coagulation pathways. Phospholipid, and activator, and calcium are mixed into an anticoagulated plasma sample, and the time is measured until a thrombus forms. Evidence: TAS. Frequency: Very frequent (HP:0040281). (ORPHA:98879)
- Spontaneous, recurrent epistaxis (HP:0004406). Evidence: TAS. Frequency: Very frequent (HP:0040281). (ORPHA:98879)
- Prolonged bleeding after surgery (HP:0004846): Bleeding that persists longer than the normal time following a surgical procedure. Evidence: TAS. Frequency: Very frequent (HP:0040281). (ORPHA:98879)
- Joint hemorrhage (HP:0005261): Hemorrhage occurring within a joint. Evidence: TAS. Frequency: Very frequent (HP:0040281). (ORPHA:98879)
- Prolonged bleeding after dental extraction (HP:0006298): Prolonged bleeding post dental extraction sufficient to require medical intervention. Evidence: TAS. Frequency: Very frequent (HP:0040281). (ORPHA:98879)
- Reduced factor IX activity (HP:0011858): Decreased activity of coagulation factor IX. Factor IX, which itself is activated by factor Xa or factor VIIa to form factor IXa, activates factor X into factor Xa. Evidence: TAS. Frequency: Very frequent (HP:0040281). (ORPHA:98879)
- Intramuscular hematoma (HP:0012233): Blood clot formed within muscle tissue following leakage of blood into the tissue. Evidence: TAS. Frequency: Very frequent (HP:0040281). (ORPHA:98879)
- Cephalohematoma (HP:0012541): Hemorrhage between the skull and periosteum of a newborn resulting from rupture of blood vessels that cross the periosteum. Evidence: TAS. Frequency: Very frequent (HP:0040281). (ORPHA:98879)
- Delayed onset bleeding (HP:0040232): Abnormal bleeding related to a procedure or trauma which does not start at the time of the initial insult, but after delay by at least 24 hours. Evidence: TAS. Frequency: Very frequent (HP:0040281). (ORPHA:98879)
- Menometrorrhagia (HP:0400008): Prolonged/excessive menses and bleeding at irregular intervals. Evidence: TAS. Frequency: Very frequent (HP:0040281). (ORPHA:98879)
These phenotypes are associated with the disease Hemophilia B (ORPHA:98879).